- Amelogenesis imperfecta (HP:0000705): A developmental dysplasia of the dental enamel. Evidence: IEA. (OMIM:301201)
- X-linked inheritance (HP:0001417): A mode of inheritance that is observed for traits related to a gene encoded on the X chromosome. Evidence: IEA. (OMIM:301201)
These phenotypes are associated with the disease X-linked amelogenesis imperfecta hypoplastic/hypomaturation 2 (OMIM:301201).